Phenotypes associated with the disease hyperbilirubinemia, conjugated, type 3 (OMIM:237550):
- Conjugated hyperbilirubinemia (HP:0002908). Evidence: IEA. (OMIM:237550)
- Autosomal recessive inheritance (HP:0000007): A mode of inheritance that is observed for traits related to a gene encoded on one of the autosomes (i.e., the human chromosomes 1-22) in which a trait manifests in individuals with two pathogenic alleles, either homozygotes (two copies of the same mutant allele) or compound heterozygotes (whereby each copy of a gene has a distinct mutant allele). Evidence: IEA. (OMIM:237550)
- Jaundice (HP:0000952): Yellow pigmentation of the skin due to bilirubin, which in turn is the result of increased bilirubin concentration in the bloodstream. Evidence: IEA. (OMIM:237550)